- Ocular hypertension (HP:0007906): Intraocular pressure that is 2 standard deviations above the population mean. Evidence: PCS. (PMID:10037570)
- Open angle glaucoma (HP:0012108): A type of glaucoma defined by an open, normal appearing anterior chamber angle and raised intraocular pressure,. Evidence: PCS. (PMID:22156576)
- Increased cup-to-disc ratio (HP:0012796): An elevation in the ratio of the diameter of the cup of the optic disc to the total diameter of the disk. The optic disc has an orange-pink rim with a pale center (the cup) that does not contain neuroretinal tissue. An increase in this ratio therefore may indicate a decrease in the quantity of healthy neuroretinal cells. Evidence: PCS. (PMID:10037570)
- Glaucomatous visual field defect (HP:0007854). Evidence: PCS. (PMID:10037570)
- Autosomal dominant inheritance (HP:0000006): A mode of inheritance that is observed for traits related to a gene encoded on one of the autosomes (i.e., the human chromosomes 1-22) in which a trait manifests in heterozygotes. In the context of medical genetics, an autosomal dominant disorder is caused when a single copy of the mutant allele is present. Males and females are affected equally, and can both transmit the disorder with a risk of 50% for each child of inheriting the mutant allele. Evidence: PCS. (PMID:22156576)
These phenotypes are associated with the disease Glaucoma 1, open angle, F (OMIM:603383).